Phenotypes associated with the disease myopia 8 (OMIM:609257):
- Myopia (HP:0000545): An abnormality of refraction characterized by the ability to see objects nearby clearly, while objects in the distance appear blurry. Evidence: TAS. (OMIM:609257)